- Progressive (HP:0003676): Applies to a disease manifestation that increases in scope or severity over the course of time, i.e., that worsens with age. Evidence: IEA. (OMIM:190300)
- Action tremor (HP:0002345): A tremor present when the limbs are active, either when outstretched in a certain position or throughout a voluntary movement. Evidence: TAS. (OMIM:190300)
- Hand tremor (HP:0002378): An unintentional, oscillating to-and-fro muscle movement affecting the hand. Evidence: TAS. (OMIM:190300)
- Dysarthria (HP:0001260): Dysarthric speech is a general description referring to a neurological speech disorder characterized by poor articulation. Depending on the involved neurological structures, dysarthria may be further classified as spastic, flaccid, ataxic, hyperkinetic and hypokinetic, or mixed. Evidence: TAS. (OMIM:190300)
- Postural tremor (HP:0002174): A type of tremors that is triggered by holding a limb in a fixed position. Evidence: TAS. (OMIM:190300)
- Autosomal dominant inheritance (HP:0000006): A mode of inheritance that is observed for traits related to a gene encoded on one of the autosomes (i.e., the human chromosomes 1-22) in which a trait manifests in heterozygotes. In the context of medical genetics, an autosomal dominant disorder is caused when a single copy of the mutant allele is present. Males and females are affected equally, and can both transmit the disorder with a risk of 50% for each child of inheriting the mutant allele. Evidence: IEA. (OMIM:190300)
These phenotypes are associated with the disease tremor, hereditary essential, 1 (OMIM:190300).